- Intermittent diarrhea (HP:0002254): Repeated episodes of diarrhea separated by periods without diarrhea. Evidence: TAS. (OMIM:269650)
- Decreased secretory IgA concentration (HP:0004433): Deficiency of secretory IgA (polymers of 2-4 IgA monomers are linked by two additional chains) and is the primary antibody response at the mucosal level, where it forms immune complexes with pathogens and allergens. Evidence: IEA. (OMIM:269650)
- Chronic intestinal candidiasis (HP:0005411): Persistent overgrowth of Candida albicans in the gastrointestinal tract. Evidence: IEA. (OMIM:269650)
- Autosomal recessive inheritance (HP:0000007): A mode of inheritance that is observed for traits related to a gene encoded on one of the autosomes (i.e., the human chromosomes 1-22) in which a trait manifests in individuals with two pathogenic alleles, either homozygotes (two copies of the same mutant allele) or compound heterozygotes (whereby each copy of a gene has a distinct mutant allele). Evidence: IEA. (OMIM:269650)
These phenotypes are associated with the disease secretory component deficiency (OMIM:269650).